Phenotypes associated with the disease autosomal recessive nonsyndromic hearing loss 51 (OMIM:609941):
- Sensorineural hearing impairment (HP:0000407): A type of hearing impairment in one or both ears related to an abnormal functionality of the cochlear nerve. Evidence: PCS. Onset: Infantile onset (HP:0003593). (PMID:16158433)
- Autosomal recessive inheritance (HP:0000007): A mode of inheritance that is observed for traits related to a gene encoded on one of the autosomes (i.e., the human chromosomes 1-22) in which a trait manifests in individuals with two pathogenic alleles, either homozygotes (two copies of the same mutant allele) or compound heterozygotes (whereby each copy of a gene has a distinct mutant allele). Evidence: PCS. (PMID:16158433)